- Language impairment (HP:0002463): Language impairment is a deficit in comprehension or production of language that includes reduced vocabulary, limited sentence structure, or impairments in written or spoken communication. Language abilities are substantially and quantifiably below age expectations. Evidence: PCS. (PMID:31664034)
- Delayed speech and language development (HP:0000750): A degree of language development that is significantly below the norm for a child of a specified age. Evidence: PCS. Frequency: 26/26. (PMID:23810381)
- Autistic behavior (HP:0000729): Persistent deficits in social interaction and communication and interaction as well as a markedly restricted repertoire of activity and interest as well as repetitive patterns of behavior. Evidence: TAS. Frequency: 4/15. (PMID:31664034)
- Global developmental delay (HP:0001263): A delay in the achievement of motor or mental milestones in the domains of development of a child, including motor skills, speech and language, cognitive skills, and social and emotional skills. This term should only be used to describe children younger than five years of age. Evidence: PCS. Frequency: 4/15. (PMID:31664034)
- Typified by incomplete penetrance (HP:0003829): Description of conditions in which not all individuals with a given genotype exhibit the disease. Penetrance is the proportion that develop disease given a lifespan of 80 years. Evidence: PCS. (PMID:31664034)
- Hyperintensity of cerebral white matter on MRI (HP:0030890): A brighter than expected signal on magnetic resonance imaging emanating from the cerebral white matter. Evidence: PCS. Frequency: 22/31. (PMID:23810381)
- Autosomal dominant inheritance (HP:0000006): A mode of inheritance that is observed for traits related to a gene encoded on one of the autosomes (i.e., the human chromosomes 1-22) in which a trait manifests in heterozygotes. In the context of medical genetics, an autosomal dominant disorder is caused when a single copy of the mutant allele is present. Males and females are affected equally, and can both transmit the disorder with a risk of 50% for each child of inheriting the mutant allele. Evidence: PCS. (PMID:23810381)
These phenotypes are associated with the disease specific language impairment 5 (OMIM:615432).